- Liposarcoma (HP:0012034): Malignant neoplasms which probably originate in primitive mesenchymal stem cell populations differentiating down a lipomatous pathway. Evidence: TAS. Frequency: Obligate (HP:0040280). (ORPHA:99969)
- Subcutaneous nodule (HP:0001482): Slightly elevated lesions on or in the skin with a diameter of over 5 mm. Evidence: TAS. Frequency: Very frequent (HP:0040281). (ORPHA:99969)
These phenotypes are associated with the disease Pleomorphic liposarcoma (ORPHA:99969).